- Cervical ribs (HP:0000891). Evidence: IEA. (OMIM:117900)
- Abnormality of the nervous system (HP:0000707): An abnormality of the nervous system. Evidence: IEA. (OMIM:117900)
- Autosomal dominant inheritance (HP:0000006): A mode of inheritance that is observed for traits related to a gene encoded on one of the autosomes (i.e., the human chromosomes 1-22) in which a trait manifests in heterozygotes. In the context of medical genetics, an autosomal dominant disorder is caused when a single copy of the mutant allele is present. Males and females are affected equally, and can both transmit the disorder with a risk of 50% for each child of inheriting the mutant allele. Evidence: IEA. (OMIM:117900)
These phenotypes are associated with the disease cervical rib disease (OMIM:117900).